- Congenital ptosis (HP:0007970). Evidence: TAS. (OMIM:154600)
- Unilateral ptosis (HP:0007687): A unilateral form of ptosis. Evidence: TAS. (OMIM:154600)
- Autosomal dominant inheritance (HP:0000006): A mode of inheritance that is observed for traits related to a gene encoded on one of the autosomes (i.e., the human chromosomes 1-22) in which a trait manifests in heterozygotes. In the context of medical genetics, an autosomal dominant disorder is caused when a single copy of the mutant allele is present. Males and females are affected equally, and can both transmit the disorder with a risk of 50% for each child of inheriting the mutant allele. Evidence: TAS. (OMIM:154600)
These phenotypes are associated with the disease jaw-winking syndrome (OMIM:154600).